Phenotypes associated with the disease Eng-Strom syndrome (ORPHA:1937):
- Pectus excavatum (HP:0000767): A defect of the chest wall characterized by a depression of the sternum, giving the chest ("pectus") a caved-in ("excavatum") appearance. Evidence: TAS. Frequency: Frequent (HP:0040282). (ORPHA:1937)
- Brachydactyly (HP:0001156): Digits that appear disproportionately short compared to the hand/foot. The word brachydactyly is used here to describe a series distinct patterns of shortened digits (brachydactyly types A-E). This is the sense used here. Evidence: TAS. Frequency: Frequent (HP:0040282). (ORPHA:1937)
- Arthritis (HP:0001369): Inflammation of a joint. Evidence: TAS. Frequency: Frequent (HP:0040282). (ORPHA:1937)
- Intrauterine growth retardation (HP:0001511): An abnormal restriction of fetal growth with fetal weight below the tenth percentile for gestational age. Evidence: TAS. Frequency: Very frequent (HP:0040281). (ORPHA:1937)
- Ventricular septal defect (HP:0001629): A hole between the two bottom chambers (ventricles) of the heart. The defect is centered around the most superior aspect of the ventricular septum. Evidence: TAS. Frequency: Frequent (HP:0040282). (ORPHA:1937)
- Abnormal cardiac septum morphology (HP:0001671): An anomaly of the intra-atrial or intraventricular septum. Evidence: TAS. Frequency: Frequent (HP:0040282). (ORPHA:1937)
- Scoliosis (HP:0002650): The presence of an abnormal lateral curvature of the spine. Evidence: TAS. Frequency: Frequent (HP:0040282). (ORPHA:1937)
- Short stature (HP:0004322): A height below that which is expected according to age and gender norms. Although there is no universally accepted definition of short stature, many refer to "short stature" as height more than 2 standard deviations below the mean for age and gender (or below the 3rd percentile for age and gender dependent norms). Evidence: TAS. Frequency: Very frequent (HP:0040281). (ORPHA:1937)
- Camptodactyly of finger (HP:0100490): The distal interphalangeal joint and/or the proximal interphalangeal joint of the fingers cannot be extended to 180 degrees by either active or passive extension. Evidence: TAS. Frequency: Very frequent (HP:0040281). (ORPHA:1937)